- Neoplasm of the larynx (HP:0100605). Evidence: TAS. Frequency: Obligate (HP:0040280). (ORPHA:100083)
- Neuroendocrine neoplasm (HP:0100634): A tumor that originates from a neuroendocrine cell. Evidence: TAS. Frequency: Obligate (HP:0040280). (ORPHA:100083)
- Dysphonia (HP:0001618): Difficulty in speaking due to a physical disorder of the mouth, tongue, throat, or vocal cords. Associated with a known physical or neurological cause. Evidence: TAS. Frequency: Frequent (HP:0040282). (ORPHA:100083)
- Weight loss (HP:0001824): Reduction of total body weight. Evidence: TAS. Frequency: Frequent (HP:0040282). (ORPHA:100083)
- Anorexia (HP:0002039): Lack of desire to eat (loss of appetite). Evidence: TAS. Frequency: Frequent (HP:0040282). (ORPHA:100083)
- Chronic noninfectious lymphadenopathy (HP:0002730): A chronic form of lymphadenopathy that is not related to infection. Evidence: TAS. Frequency: Frequent (HP:0040282). (ORPHA:100083)
- Exertional dyspnea (HP:0002875): Perceived difficulty to breathe that occurs with exercise or exertion and improves with rest. Evidence: TAS. Frequency: Frequent (HP:0040282). (ORPHA:100083)
- Increased serum serotonin (HP:0003144): A increased concentration of serotonin in the blood. Evidence: TAS. Frequency: Frequent (HP:0040282). (ORPHA:100083)
- Elevated circulating calcitonin concentration (HP:0003528): Concentration of calcitonin, a 32-amino acid polypeptide hormone that is produced primarily by the parafollicular cells of the thyroid, in the blood circulation above the upper limit of normal. Evidence: TAS. Frequency: Frequent (HP:0040282). (ORPHA:100083)
- Chronic fatigue (HP:0012432): Subjective feeling of tiredness characterized by a lack of energy and motivation that persists for six months or longer. Evidence: TAS. Frequency: Frequent (HP:0040282). (ORPHA:100083)
- Oral-pharyngeal dysphagia (HP:0200136). Evidence: TAS. Frequency: Frequent (HP:0040282). (ORPHA:100083)
- Adrenocorticotropic hormone excess (HP:0011749): Overproduction of adrenocorticotropic hormone (ACTH), which generally leads secondarily to overproduction of cortisol by the adrenal cortex. Evidence: TAS. Frequency: Very rare (HP:0040284). (ORPHA:100083)
- Elevated circulating CEA concentration (HP:0031029): The concentration of CEA (carcinoembryonic antigen) in the blood circulation is above the upper limit of normal. Evidence: TAS. Frequency: Very rare (HP:0040284). (ORPHA:100083)
- Inappropriate antidiuretic hormone secretion (HP:0031218): A state of increased circulating antidiuretic hormone despite hyponatremia and hypo-osmolality with normal or increased plasma volume. Evidence: TAS. Frequency: Very rare (HP:0040284). (ORPHA:100083)
These phenotypes are associated with the disease Laryngeal neuroendocrine tumor (ORPHA:100083).